Phenotypes associated with the disease esophageal ring, lower (OMIM:133240):
- Hiatus hernia (HP:0002036): The presence of a hernia in which the upper part of the stomach, i.e., mainly the gastric cardia protrudes through the diaphragmatic esophageal hiatus. Evidence: IEA. (OMIM:133240)
- Dysphagia (HP:0002015): Difficulty in swallowing. Evidence: IEA. (OMIM:133240)
- Autosomal dominant inheritance (HP:0000006): A mode of inheritance that is observed for traits related to a gene encoded on one of the autosomes (i.e., the human chromosomes 1-22) in which a trait manifests in heterozygotes. In the context of medical genetics, an autosomal dominant disorder is caused when a single copy of the mutant allele is present. Males and females are affected equally, and can both transmit the disorder with a risk of 50% for each child of inheriting the mutant allele. Evidence: IEA. (OMIM:133240)